- Constriction of peripheral visual field (HP:0001133): An absolute or relative decrease in retinal sensitivity extending from edge (periphery) of the visual field in a concentric pattern. The visual field is the area that is perceived simultaneously by a fixating eye. Evidence: PCS. Frequency: 3/3. (PMID:25882705)
- Spicular pigmentation of the retina (HP:0007737): Pigment migration into the retina in a bone-spicule configuration (resembling the nucleated cells within the lacuna of bone). Evidence: PCS. Frequency: 3/3. (PMID:25882705)
- Nyctalopia (HP:0000662): Inability to see well at night or in poor light. Evidence: PCS. Frequency: 3/3. (PMID:25882705)
- Middle age onset (HP:0003596): A type of adult onset with onset of symptoms at the age of 40 to 60 years. Evidence: PCS. Frequency: 1/3. (PMID:25882705)
- High myopia (HP:0011003): A severe form of myopia with greater than -6.00 diopters. Evidence: PCS. Frequency: 1/3. (PMID:25882705)
- Peripapillary atrophy (HP:0500087): Thinning in the layers of the retina and retinal pigment epithelium around the optic nerve. Evidence: PCS. Frequency: 1/3. (PMID:25882705)
- Young adult onset (HP:0011462): Onset of disease at the age of between 16 and 40 years. Evidence: PCS. Frequency: 2/3. (PMID:25882705)
- Photophobia (HP:0000613): Excessive sensitivity to light with the sensation of discomfort or pain in the eyes due to exposure to bright light. Evidence: PCS. Frequency: 2/3. (PMID:25882705)
- Reduced visual acuity (HP:0007663). Evidence: PCS. Frequency: 3/3. (PMID:25882705)
- Autosomal recessive inheritance (HP:0000007): A mode of inheritance that is observed for traits related to a gene encoded on one of the autosomes (i.e., the human chromosomes 1-22) in which a trait manifests in individuals with two pathogenic alleles, either homozygotes (two copies of the same mutant allele) or compound heterozygotes (whereby each copy of a gene has a distinct mutant allele). Evidence: PCS. (PMID:25882705)
- Optic disc pallor (HP:0000543): A pale yellow discoloration of the optic disc (the area of the optic nerve head in the retina). The optic disc normally has a pinkish hue with a central yellowish depression. Evidence: PCS. Frequency: 3/3. (PMID:25882705)
- Posterior subcapsular cataract (HP:0007787): A type of cataract affecting the posterior pole of lens immediately adjacent to ('beneath') the Lens capsule. Evidence: PCS. Frequency: 3/3. (PMID:25882705)
- Rod-cone dystrophy (HP:0000510): An inherited retinal disease subtype in which the rod photoreceptors appear to be more severely affected than the cone photoreceptors. Typical presentation is with nyctalopia (due to rod dysfunction) followed by loss of mid-peripheral field of vision, which gradually extends and leaves many patients with a small central island of vision due to the preservation of macular cones. Evidence: PCS. Frequency: 3/3. (PMID:25882705)
- Attenuation of retinal blood vessels (HP:0007843): Narrowing of the retinal blood vessels, both arterioles and venules. Evidence: PCS. Frequency: 3/3. (PMID:25882705)
These phenotypes are associated with the disease retinitis pigmentosa 72 (OMIM:616469).